Phenotypes associated with the disease Reis-Bucklers corneal dystrophy (OMIM:608470):
- Opacification of the corneal stroma (HP:0007759): Reduced transparency of the stroma of cornea. Evidence: PCS. Frequency: 2/2. (PMID:16606891)
- Corneal opacity (HP:0007957): A reduction of corneal clarity. Evidence: PCS. Frequency: 7/7. (PMID:9727509)
- Strabismus (HP:0000486): A misalignment of the eyes so that the visual axes deviate from bifoveal fixation. The classification of strabismus may be based on a number of features including the relative position of the eyes, whether the deviation is latent or manifest, intermittent or constant, concomitant or otherwise and according to the age of onset and the relevance of any associated refractive error. Evidence: TAS. (OMIM:608470)
- Corneal dystrophy (HP:0001131): The term corneal dystrophy embraces a heterogenous group of bilateral genetically determined non-inflammatory corneal diseases that are restricted to the cornea. Evidence: PCS. Frequency: 9/9. (PMID:9727509;PMID:16606891)
- Infantile onset (HP:0003593): Onset of signs or symptoms of disease between 28 days to one year of life. Evidence: PCS. Frequency: 2/2. (PMID:16606891)
- Photophobia (HP:0000613): Excessive sensitivity to light with the sensation of discomfort or pain in the eyes due to exposure to bright light. Evidence: PCS. Frequency: 1/2. (PMID:16606891)
- Reduced visual acuity (HP:0007663). Evidence: PCS. Frequency: 3/7. (PMID:9727509)
- Corneal erosion (HP:0200020): An erosion or abrasion of the cornea's outermost layer of epithelial cells. Evidence: PCS. Frequency: 2/2. (PMID:16606891)
- Autosomal dominant inheritance (HP:0000006): A mode of inheritance that is observed for traits related to a gene encoded on one of the autosomes (i.e., the human chromosomes 1-22) in which a trait manifests in heterozygotes. In the context of medical genetics, an autosomal dominant disorder is caused when a single copy of the mutant allele is present. Males and females are affected equally, and can both transmit the disorder with a risk of 50% for each child of inheriting the mutant allele. Evidence: PCS. (PMID:9054935)
- Palpebral edema (HP:0100540): Edema in the region of the eyelids. Evidence: PCS. Frequency: 1/2. (PMID:16606891)